Phenotypes associated with the disease nonpapillary renal cell carcinoma (OMIM:144700):
- Renal cell carcinoma (HP:0005584): A type of carcinoma of the kidney with origin in the epithelium of the proximal convoluted renal tubule. Evidence: TAS. (OMIM:144700)
- Sporadic (HP:0003745): Cases of the disease in question occur without a previous family history, i.e., as isolated cases without being transmitted from a parent and without other siblings being affected. Evidence: TAS. (OMIM:144700)